Phenotypes associated with the disease Familial avascular necrosis of femoral head (ORPHA:86820):
- Abnormal femoral neck/head morphology (HP:0003366). Evidence: TAS. Frequency: Very frequent (HP:0040281). (ORPHA:86820)
- Groin pain (HP:0031520): An unpleasant sensation characterized by physical discomfort (such as pricking, throbbing, or aching) localized to the groin region. Evidence: TAS. Frequency: Very frequent (HP:0040281). (ORPHA:86820)
- Short stepped shuffling gait (HP:0007311). Evidence: TAS. Frequency: Frequent (HP:0040282). (ORPHA:86820)
- Limited hip movement (HP:0008800): A decreased ability to move the femur at the hip joint associated with a decreased range of motion of the hip. Evidence: TAS. Frequency: Frequent (HP:0040282). (ORPHA:86820)
- Flattened femoral head (HP:0008812): An abnormally flattened femoral head. Evidence: TAS. Frequency: Frequent (HP:0040282). (ORPHA:86820)
- Hip osteoarthritis (HP:0008843). Evidence: TAS. Frequency: Frequent (HP:0040282). (ORPHA:86820)
- Hip pain (HP:0030838): An unpleasant sensation characterized by physical discomfort (such as pricking, throbbing, or aching) localized to the hip. Evidence: TAS. Frequency: Frequent (HP:0040282). (ORPHA:86820)
- Impairment of activities of daily living (HP:0031058): Difficulty in performing one or more activities normally performed every day, such as eating, bathing, dressing, grooming, work, homemaking, and leisure. Evidence: TAS. Frequency: Frequent (HP:0040282). (ORPHA:86820)
- Lower limb asymmetry (HP:0100559): A difference in length or diameter between the left and right leg. Evidence: TAS. Frequency: Frequent (HP:0040282). (ORPHA:86820)